Phenotypes associated with the disease X-linked complicated corpus callosum dysgenesis (ORPHA:1497):
- Microcephaly (HP:0000252): Head circumference below 2 standard deviations below the mean for age and gender. Evidence: TAS. Frequency: Frequent (HP:0040282). (ORPHA:1497)
- Intellectual disability (HP:0001249): The term intellectual disability or intellectual developmental disorder is used to describe significantly sub-average intellectual and adaptive functioning based on clinical assessment and as measured by individually administered, appropriately normed, standardized and validated tests of intellectual functioning and adaptive behavior, with onset during the developmental period from infancy through adolescence. Evidence: TAS. Frequency: Very frequent (HP:0040281). (ORPHA:1497)
- Seizure (HP:0001250): A seizure is an intermittent abnormality of nervous system physiology characterized by a transient occurrence of signs and/or symptoms due to abnormal excessive or synchronous neuronal activity in the brain. Evidence: TAS. Frequency: Very frequent (HP:0040281). (ORPHA:1497)
- Spasticity (HP:0001257): A motor disorder characterized by a velocity-dependent increase in tonic stretch reflexes with increased muscle tone, exaggerated (hyperexcitable) tendon reflexes. Evidence: TAS. Frequency: Frequent (HP:0040282). (ORPHA:1497)
- Cerebellar hypoplasia (HP:0001321): Cerebellar hypoplasia is a descriptive term implying a cerebellum with a reduced volume, but a normal shape and is stable over time. Evidence: TAS. Frequency: Frequent (HP:0040282). (ORPHA:1497)
- Muscle weakness (HP:0001324): Reduced strength of muscles. Evidence: TAS. Frequency: Frequent (HP:0040282). (ORPHA:1497)
- Aganglionic megacolon (HP:0002251): An abnormality resulting from a lack of intestinal ganglion cells (i.e., an aganglionic section of bowel) that results in bowel obstruction with enlargement of the colon. Evidence: TAS. Frequency: Occasional (HP:0040283). (ORPHA:1497)